- Protein-losing enteropathy (HP:0002243): Abnormal loss of protein from the digestive tract related to excessive leakage of plasma proteins into the lumen of the gastrointestinal tract. Evidence: IEA. (OMIM:175500)
- Alopecia (HP:0001596): A noncongenital process of hair loss, which may progress to partial or complete baldness. Evidence: IEA. (OMIM:175500)
- Malabsorption (HP:0002024): Impaired ability to absorb one or more nutrients from the intestine. Evidence: IEA. (OMIM:175500)
- Nail dysplasia (HP:0002164): The presence of developmental dysplasia of the nail. Evidence: IEA. (OMIM:175500)
- Thromboembolism (HP:0001907): The formation of a blood clot inside a blood vessel that subsequently travels through the blood stream from the site where it formed to another location in the body, generally leading to vascular occlusion at the distant site. Evidence: IEA. (OMIM:175500)
- Cataract (HP:0000518): A cataract is an opacity or clouding that develops in the crystalline lens of the eye or in its capsule. Evidence: IEA. (OMIM:175500)
- Hypomagnesemia (HP:0002917): The concentration of magnesium in the blood circulation is below the lower limit of normal. Evidence: IEA. (OMIM:175500)
- Anemia (HP:0001903): A reduction in erythrocytes volume or hemoglobin concentration. Evidence: IEA. (OMIM:175500)
- Xerostomia (HP:0000217): Dryness of the mouth due to salivary gland dysfunction. Evidence: IEA. (OMIM:175500)
- Hyperpigmentation of the skin (HP:0000953): A darkening of the skin related to an increase in melanin production and deposition. Evidence: IEA. (OMIM:175500)
- Sporadic (HP:0003745): Cases of the disease in question occur without a previous family history, i.e., as isolated cases without being transmitted from a parent and without other siblings being affected. Evidence: IEA. (OMIM:175500)
- Muscle weakness (HP:0001324): Reduced strength of muscles. Evidence: IEA. (OMIM:175500)
- Anorexia (HP:0002039): Lack of desire to eat (loss of appetite). Evidence: IEA. (OMIM:175500)
- Diarrhea (HP:0002014): Abnormally increased frequency (usually defined as three or more) loose or watery bowel movements a day. Evidence: IEA. (OMIM:175500)
- Paresthesia (HP:0003401): Abnormal sensations such as tingling, pricking, or numbness of the skin with no apparent physical cause. Evidence: IEA. (OMIM:175500)
- Hematochezia (HP:0002573): The passage of fresh (red) blood per anus, usually in or with stools. Most rectal bleeding comes from the colon, rectum, or anus. Evidence: IEA. (OMIM:175500)
- Gastrointestinal carcinoma (HP:0002672). Evidence: IEA. (OMIM:175500)
- Vomiting (HP:0002013): Forceful ejection of the contents of the stomach through the mouth by means of a series of involuntary spasmic contractions. Evidence: IEA. (OMIM:175500)
- Hamartomatous polyposis (HP:0004390): Polyp-like protrusions which are histologically hamartomas. These can occur throughout the gastrointestinal tract. Hamartomatous polyps are composed of the normal cellular elements of the gastrointestinal tract, but have a markedly distorted architecture. Evidence: TAS. (OMIM:175500)
- Clubbing of fingers (HP:0100759): Terminal broadening of the fingers (distal phalanges of the fingers). Evidence: TAS. (OMIM:175500)
- Glossitis (HP:0000206): Inflammation of the tongue. Evidence: IEA. (OMIM:175500)
- Clubbing (HP:0001217): Broadening of the soft tissues (non-edematous swelling of soft tissues) of the digital tips in all dimensions associated with an increased longitudinal and lateral curvature of the nails. Evidence: IEA. (OMIM:175500)
- Hypokalemia (HP:0002900): The concentration of potassium(1+) in the blood circulation is below the lower limit of normal. Evidence: IEA. (OMIM:175500)
- Hypocalcemia (HP:0002901): The concentration of calcium in the blood circulation is below the lower limit of normal. Evidence: IEA. (OMIM:175500)
- Nail dystrophy (HP:0008404): Onychodystrophy (nail dystrophy) refers to nail changes apart from changes of the color (nail dyschromia) and involves partial or complete disruption of the various keratinous layers of the nail plate. Evidence: TAS. (OMIM:175500)
- Abdominal pain (HP:0002027): An unpleasant sensation characterized by physical discomfort (such as pricking, throbbing, or aching) and perceived to originate in the abdomen. Evidence: IEA. (OMIM:175500)
- Cachexia (HP:0004326): Severe weight loss, wasting of muscle, loss of appetite, and general debility related to a chronic disease. Evidence: IEA. (OMIM:175500)
These phenotypes are associated with the disease Cronkhite-Canada syndrome (OMIM:175500).